- Moderate intellectual disability (HP:0002342): Moderate intellectual disability (ID) is defined as a type of ID characterized by moderately sub-average adaptive functioning and intellectual functioning, with an intelligence quotient (IQ) the range of 35-49. Evidence: PCS. Frequency: 2/2. (PMID:17671655)
- Hypomagnesemia (HP:0002917): The concentration of magnesium in the blood circulation is below the lower limit of normal. Evidence: PCS. Frequency: 2/2. (PMID:17671655)
- Seizure (HP:0001250): A seizure is an intermittent abnormality of nervous system physiology characterized by a transient occurrence of signs and/or symptoms due to abnormal excessive or synchronous neuronal activity in the brain. Evidence: PCS. Frequency: 2/2. (PMID:17671655)
- Global developmental delay (HP:0001263): A delay in the achievement of motor or mental milestones in the domains of development of a child, including motor skills, speech and language, cognitive skills, and social and emotional skills. This term should only be used to describe children younger than five years of age. Evidence: PCS. Frequency: 2/2. (PMID:17671655)
- Autosomal recessive inheritance (HP:0000007): A mode of inheritance that is observed for traits related to a gene encoded on one of the autosomes (i.e., the human chromosomes 1-22) in which a trait manifests in individuals with two pathogenic alleles, either homozygotes (two copies of the same mutant allele) or compound heterozygotes (whereby each copy of a gene has a distinct mutant allele). Evidence: PCS. (PMID:17671655)
These phenotypes are associated with the disease renal hypomagnesemia 4 (OMIM:611718).